Phenotypes associated with the disease autosomal recessive nonsyndromic hearing loss 74 (OMIM:613718):
- Congenital onset (HP:0003577): A phenotypic abnormality that is present at birth. Evidence: PCS. (PMID:21185009)
- Hearing impairment (HP:0000365): A decreased magnitude of the sensory perception of sound. Evidence: PCS. (PMID:21185009)
- Autosomal recessive inheritance (HP:0000007): A mode of inheritance that is observed for traits related to a gene encoded on one of the autosomes (i.e., the human chromosomes 1-22) in which a trait manifests in individuals with two pathogenic alleles, either homozygotes (two copies of the same mutant allele) or compound heterozygotes (whereby each copy of a gene has a distinct mutant allele). Evidence: PCS. (PMID:21185009)
- Rod-cone dystrophy (HP:0000510): An inherited retinal disease subtype in which the rod photoreceptors appear to be more severely affected than the cone photoreceptors. Typical presentation is with nyctalopia (due to rod dysfunction) followed by loss of mid-peripheral field of vision, which gradually extends and leaves many patients with a small central island of vision due to the preservation of macular cones. Evidence: PCS. Frequency: 0/6. (PMID:21185009)